Phenotypes associated with the disease Riboflavin transporter deficiency (ORPHA:97229):
- Bulbar palsy (HP:0001283): Bulbar weakness (or bulbar palsy) refers to bilateral impairment of function of the lower cranial nerves IX, X, XI and XII, which occurs due to lower motor neuron lesion either at nuclear or fascicular level in the medulla or from bilateral lesions of the lower cranial nerves outside the brain-stem. Bulbar weakness is often associated with difficulty in chewing, weakness of the facial muscles, dysarthria, palatal weakness and regurgitation of fluids, dysphagia, and dysphonia. Evidence: TAS. Frequency: Very frequent (HP:0040281). (ORPHA:97229)
- Abnormal cranial nerve morphology (HP:0001291): Structural abnormality affecting one or more of the cranial nerves, which emerge directly from the brain stem. Evidence: TAS. Frequency: Very frequent (HP:0040281). (ORPHA:97229)
- Progressive hearing impairment (HP:0001730): A progressive form of hearing impairment. Evidence: TAS. Frequency: Very frequent (HP:0040281). (ORPHA:97229)
- Cranial nerve paralysis (HP:0006824). Evidence: TAS. Frequency: Very frequent (HP:0040281). (ORPHA:97229)
- Abnormality of eye movement (HP:0000496): An abnormality in voluntary or involuntary eye movements or their control. Evidence: TAS. Frequency: Frequent (HP:0040282). (ORPHA:97229)
- Ptosis (HP:0000508): The upper eyelid margin is positioned 3 mm or more lower than usual and covers the superior portion of the iris (objective); or, the upper lid margin obscures at least part of the pupil (subjective). Evidence: TAS. Frequency: Frequent (HP:0040282). (ORPHA:97229)
- Hypotonia (HP:0001252): Hypotonia is an abnormally low muscle tone (the amount of tension or resistance to movement in a muscle). Even when relaxed, muscles have a continuous and passive partial contraction which provides some resistance to passive stretching. Hypotonia thus manifests as diminished resistance to passive stretching. Hypotonia is not the same as muscle weakness, although the two conditions can co-exist. Evidence: TAS. Frequency: Frequent (HP:0040282). (ORPHA:97229)
- Dysarthria (HP:0001260): Dysarthric speech is a general description referring to a neurological speech disorder characterized by poor articulation. Depending on the involved neurological structures, dysarthria may be further classified as spastic, flaccid, ataxic, hyperkinetic and hypokinetic, or mixed. Evidence: TAS. Frequency: Frequent (HP:0040282). (ORPHA:97229)
- Hyporeflexia (HP:0001265): Reduction of neurologic reflexes such as the knee-jerk reaction. Evidence: TAS. Frequency: Frequent (HP:0040282). (ORPHA:97229)
- Muscle weakness (HP:0001324): Reduced strength of muscles. Evidence: TAS. Frequency: Frequent (HP:0040282). (ORPHA:97229)
- Myoclonus (HP:0001336): Very brief, involuntary random muscular contractions occurring at rest, in response to sensory stimuli, or accompanying voluntary movements. Evidence: TAS. Frequency: Frequent (HP:0040282). (ORPHA:97229)
- Dysphagia (HP:0002015): Difficulty in swallowing. Evidence: TAS. Frequency: Frequent (HP:0040282). (ORPHA:97229)
- Respiratory insufficiency (HP:0002093). Evidence: TAS. Frequency: Frequent (HP:0040282). (ORPHA:97229)
- Skeletal muscle atrophy (HP:0003202): The presence of skeletal muscular atrophy (which is also known as amyotrophy). Evidence: TAS. Frequency: Frequent (HP:0040282). (ORPHA:97229)
- Limb muscle weakness (HP:0003690): Reduced strength and weakness of the muscles of the arms and legs. Evidence: TAS. Frequency: Frequent (HP:0040282). (ORPHA:97229)
- Facial palsy (HP:0010628): Facial nerve palsy is a dysfunction of cranial nerve VII (the facial nerve) that results in inability to control facial muscles on the affected side with weakness of the muscles of facial expression and eye closure. This can either be present in unilateral or bilateral form. Evidence: TAS. Frequency: Frequent (HP:0040282). (ORPHA:97229)
- Hypogonadism (HP:0000135): A decreased functionality of the gonad. Evidence: TAS. Frequency: Occasional (HP:0040283). (ORPHA:97229)
- Visual impairment (HP:0000505): Visual impairment (or vision impairment) is vision loss (of a person) to such a degree as to qualify as an additional support need through a significant limitation of visual capability resulting from either disease, trauma, or congenital or degenerative conditions that cannot be corrected by conventional means, such as refractive correction, medication, or surgery. Evidence: TAS. Frequency: Occasional (HP:0040283). (ORPHA:97229)
- Optic disc pallor (HP:0000543): A pale yellow discoloration of the optic disc (the area of the optic nerve head in the retina). The optic disc normally has a pinkish hue with a central yellowish depression. Evidence: TAS. Frequency: Occasional (HP:0040283). (ORPHA:97229)
- Color vision defect (HP:0000551): An anomaly in the ability to discriminate between or recognize colors. Evidence: TAS. Frequency: Occasional (HP:0040283). (ORPHA:97229)
- Aggressive behavior (HP:0000718): Behavior or an act aimed at harming a person, animal, or physical property (e.g., acts of physical violence; shouting, swearing, and using harsh language; slashing someone's tires). Evidence: TAS. Frequency: Occasional (HP:0040283). (ORPHA:97229)
- Hallucinations (HP:0000738): Perceptions in a conscious and awake state that, in the absence of external stimuli, have qualities of real perception. These perceptions are vivid, substantial, and located in external objective space. Evidence: TAS. Frequency: Occasional (HP:0040283). (ORPHA:97229)
- Gynecomastia (HP:0000771): Abnormal development of large mammary glands in males resulting in breast enlargement. Evidence: TAS. Frequency: Occasional (HP:0040283). (ORPHA:97229)
- Hypertension (HP:0000822): The presence of chronic increased pressure in the systemic arterial system. Evidence: TAS. Frequency: Occasional (HP:0040283). (ORPHA:97229)
- Diabetes insipidus (HP:0000873): A state of excessive water intake and hypotonic (dilute) polyuria. Diabetes insipidus may be due to failure of vasopressin (AVP) release (central or neurogenic diabetes insipidus) or to a failure of the kidney to respond to AVP (nephrogenic diabetes insipidus). Evidence: TAS. Frequency: Occasional (HP:0040283). (ORPHA:97229)
- Intellectual disability (HP:0001249): The term intellectual disability or intellectual developmental disorder is used to describe significantly sub-average intellectual and adaptive functioning based on clinical assessment and as measured by individually administered, appropriately normed, standardized and validated tests of intellectual functioning and adaptive behavior, with onset during the developmental period from infancy through adolescence. Evidence: TAS. Frequency: Occasional (HP:0040283). (ORPHA:97229)
- Seizure (HP:0001250): A seizure is an intermittent abnormality of nervous system physiology characterized by a transient occurrence of signs and/or symptoms due to abnormal excessive or synchronous neuronal activity in the brain. Evidence: TAS. Frequency: Occasional (HP:0040283). (ORPHA:97229)
- Ataxia (HP:0001251): Ataxia refers to impaired coordination of voluntary muscle movement. Cerebellar ataxia refers to ataxia due to dysfunction of the cerebellum. This causes a variety of elementary neurological deficits including asynergy (lack of coordination between muscles, limbs and joints), dysmetria (lack of ability to judge distances that can lead to under- or overshoot in grasping movements), and dysdiadochokinesia (inability to perform rapid movements requiring antagonizing muscle groups to be switched on and off repeatedly). Evidence: TAS. Frequency: Occasional (HP:0040283). (ORPHA:97229)
- Tremor (HP:0001337): An unintentional, oscillating to-and-fro muscle movement about a joint axis. Evidence: TAS. Frequency: Occasional (HP:0040283). (ORPHA:97229)
- Cerebral cortical atrophy (HP:0002120): Atrophy of the cortex of the cerebrum. Evidence: TAS. Frequency: Occasional (HP:0040283). (ORPHA:97229)
- Cachexia (HP:0004326): Severe weight loss, wasting of muscle, loss of appetite, and general debility related to a chronic disease. Evidence: TAS. Frequency: Occasional (HP:0040283). (ORPHA:97229)
- Iris hypopigmentation (HP:0007730): An abnormal reduction in the amount of pigmentation of the iris. Evidence: TAS. Frequency: Occasional (HP:0040283). (ORPHA:97229)
- Abnormal macular pigmentation (HP:0008002): Any deviation from the normal, uniform distribution or appearance of pigment within the macular region of the retina. Evidence: TAS. Frequency: Occasional (HP:0040283). (ORPHA:97229)
- Sleep apnea (HP:0010535): An intermittent cessation of airflow at the mouth and nose during sleep is known as sleep apnea. Apneas that last at least 10 seconds are considered significant, but individuals with sleep apnea may experience apneas lasting from 20 seconds up to 2 or 3 minutes. Patients may have up to 15 events per hour of sleep. Evidence: TAS. Frequency: Occasional (HP:0040283). (ORPHA:97229)
- Abnormal autonomic nervous system physiology (HP:0012332): A functional abnormality of the autonomic nervous system. Evidence: TAS. Frequency: Occasional (HP:0040283). (ORPHA:97229)